- Corneal opacity (HP:0007957): A reduction of corneal clarity. Evidence: TAS. (OMIM:613267)
- Corneal stromal edema (HP:0012040): Abnormal accumulation of fluid and swelling of the stroma of cornea. Evidence: TAS. (OMIM:613267)
- Adult onset (HP:0003581): Onset of disease manifestations in adulthood, defined here as at the age of 16 years or later. Evidence: TAS. (OMIM:613267)
- Visual impairment (HP:0000505): Visual impairment (or vision impairment) is vision loss (of a person) to such a degree as to qualify as an additional support need through a significant limitation of visual capability resulting from either disease, trauma, or congenital or degenerative conditions that cannot be corrected by conventional means, such as refractive correction, medication, or surgery. Evidence: TAS. (OMIM:613267)
- Corneal guttata (HP:0012038): Corneal guttata are droplet-like accumulations of non-banded collagen on the posterior surface of Descemet's membrane. The presence of focal thickenings of Descemet's membrane histologically named guttae. Cornea guttata can be easily diagnosed in vivo and ex vivo by means of specular microscopy as it gives dark areas where no endothelial cells are visible. Evidence: TAS. (OMIM:613267)
- Autosomal dominant inheritance (HP:0000006): A mode of inheritance that is observed for traits related to a gene encoded on one of the autosomes (i.e., the human chromosomes 1-22) in which a trait manifests in heterozygotes. In the context of medical genetics, an autosomal dominant disorder is caused when a single copy of the mutant allele is present. Males and females are affected equally, and can both transmit the disorder with a risk of 50% for each child of inheriting the mutant allele. Evidence: PCS. (PMID:25722209)
These phenotypes are associated with the disease corneal dystrophy, Fuchs endothelial, 3 (OMIM:613267).